Phenotypes associated with the disease monosodium glutamate sensitivity (OMIM:231630):
- Flushing (HP:0031284): Recurrent episodes of redness of the skin together with a sensation of warmth or burning of the affected areas of skin. Evidence: PCS. Onset: Adult onset (HP:0003581). (PMID:942671)
- Dyspnea (HP:0002094): Difficult or labored breathing. Dyspnea is a subjective feeling only the patient can rate, e.g., on a Borg scale. Evidence: PCS. Onset: Adult onset (HP:0003581). (PMID:942671)
- Autosomal recessive inheritance (HP:0000007): A mode of inheritance that is observed for traits related to a gene encoded on one of the autosomes (i.e., the human chromosomes 1-22) in which a trait manifests in individuals with two pathogenic alleles, either homozygotes (two copies of the same mutant allele) or compound heterozygotes (whereby each copy of a gene has a distinct mutant allele). Evidence: IEA. (OMIM:231630)
- Chest pain (HP:0100749): An unpleasant sensation characterized by physical discomfort (such as pricking, throbbing, or aching) localized to the chest. Evidence: PCS. Onset: Adult onset (HP:0003581). (PMID:942671)
- Nausea (HP:0002018): A sensation of unease in the stomach together with an urge to vomit. Evidence: IEA. (OMIM:231630)
- Headache (HP:0002315): Cephalgia, or pain sensed in various parts of the head, not confined to the area of distribution of any nerve. Evidence: PCS. (PMID:4117590)
- Palpitations (HP:0001962): A sensation that the heart is pounding or racing, which is a non-specific sign but may be a manifestation of arrhythmia. Evidence: PCS. Onset: Adult onset (HP:0003581). (PMID:942671)